Phenotypes associated with the disease Emanuel syndrome (ORPHA:96170):
- Global developmental delay (HP:0001263): A delay in the achievement of motor or mental milestones in the domains of development of a child, including motor skills, speech and language, cognitive skills, and social and emotional skills. This term should only be used to describe children younger than five years of age. Evidence: TAS. Frequency: Very frequent (HP:0040281). (ORPHA:96170)
- Cryptorchidism (HP:0000028): Testis in inguinal canal. That is, absence of one or both testes from the scrotum owing to failure of the testis or testes to descend through the inguinal canal to the scrotum. Evidence: TAS. Frequency: Frequent (HP:0040282). (ORPHA:96170)
- Micropenis (HP:0000054): Abnormally small penis. At birth, the normal penis is about 3 cm (stretched length from pubic tubercle to tip of penis) with micropenis less than 2.0-2.5 cm. Evidence: TAS. Frequency: Frequent (HP:0040282). (ORPHA:96170)
- Hypogonadism (HP:0000135): A decreased functionality of the gonad. Evidence: TAS. Frequency: Frequent (HP:0040282). (ORPHA:96170)
- High palate (HP:0000218): Height of the palate more than 2 SD above the mean (objective) or palatal height at the level of the first permanent molar more than twice the height of the teeth (subjective). Evidence: TAS. Frequency: Frequent (HP:0040282). (ORPHA:96170)
- Long philtrum (HP:0000343): Distance between nasal base and midline upper lip vermilion border more than 2 SD above the mean. Alternatively, an apparently increased distance between nasal base and midline upper lip vermilion border. Evidence: TAS. Frequency: Frequent (HP:0040282). (ORPHA:96170)
- Micrognathia (HP:0000347): Developmental hypoplasia of the mandible. Evidence: TAS. Frequency: Frequent (HP:0040282). (ORPHA:96170)
- Hearing impairment (HP:0000365): A decreased magnitude of the sensory perception of sound. Evidence: TAS. Frequency: Frequent (HP:0040282). (ORPHA:96170)
- Low-set ears (HP:0000369): Upper insertion of the ear to the scalp below an imaginary horizontal line drawn between the inner canthi of the eye and extending posteriorly to the ear. Evidence: TAS. Frequency: Frequent (HP:0040282). (ORPHA:96170)
- Preauricular skin tag (HP:0000384): A rudimentary tag of skin often containing ear tissue including a core of cartilage and located just anterior to the auricle (outer part of the ear). Evidence: TAS. Frequency: Frequent (HP:0040282). (ORPHA:96170)
- Macrotia (HP:0000400): Median longitudinal ear length greater than two standard deviations above the mean and median ear width greater than two standard deviations above the mean (objective); or, apparent increase in length and width of the pinna (subjective). Evidence: TAS. Frequency: Frequent (HP:0040282). (ORPHA:96170)
- Recurrent otitis media (HP:0000403): Increased susceptibility to otitis media, as manifested by recurrent episodes of otitis media. Evidence: TAS. Frequency: Frequent (HP:0040282). (ORPHA:96170)
- Strabismus (HP:0000486): A misalignment of the eyes so that the visual axes deviate from bifoveal fixation. The classification of strabismus may be based on a number of features including the relative position of the eyes, whether the deviation is latent or manifest, intermittent or constant, concomitant or otherwise and according to the age of onset and the relevance of any associated refractive error. Evidence: TAS. Frequency: Frequent (HP:0040282). (ORPHA:96170)
- Deeply set eye (HP:0000490): An eye that is more deeply recessed into the plane of the face than is typical. Evidence: TAS. Frequency: Frequent (HP:0040282). (ORPHA:96170)
- Myopia (HP:0000545): An abnormality of refraction characterized by the ability to see objects nearby clearly, while objects in the distance appear blurry. Evidence: TAS. Frequency: Frequent (HP:0040282). (ORPHA:96170)
- Upslanted palpebral fissure (HP:0000582): The palpebral fissure inclination is more than two standard deviations above the mean for age (objective); or, the inclination of the palpebral fissure is greater than typical for age. Evidence: TAS. Frequency: Frequent (HP:0040282). (ORPHA:96170)
- Dental crowding (HP:0000678): Changes in alignment of teeth in the dental arch. Evidence: TAS. Frequency: Frequent (HP:0040282). (ORPHA:96170)
- Delayed eruption of teeth (HP:0000684): Delayed tooth eruption, which can be defined as tooth eruption more than 2 SD beyond the mean eruption age. Evidence: TAS. Frequency: Frequent (HP:0040282). (ORPHA:96170)
- Tooth malposition (HP:0000692): Abnormal alignment, positioning, or spacing of the teeth, i.e., misaligned teeth. Evidence: TAS. Frequency: Frequent (HP:0040282). (ORPHA:96170)
- Delayed speech and language development (HP:0000750): A degree of language development that is significantly below the norm for a child of a specified age. Evidence: TAS. Frequency: Frequent (HP:0040282). (ORPHA:96170)
- Infertility (HP:0000789). Evidence: TAS. Frequency: Frequent (HP:0040282). (ORPHA:96170)
- Single umbilical artery (HP:0001195): Single umbilical artery (SUA) is the absence of one of the two umbilical arteries surrounding the fetal bladder and in the fetal umbilical cord. Evidence: TAS. Frequency: Frequent (HP:0040282). (ORPHA:96170)
- Intellectual disability (HP:0001249): The term intellectual disability or intellectual developmental disorder is used to describe significantly sub-average intellectual and adaptive functioning based on clinical assessment and as measured by individually administered, appropriately normed, standardized and validated tests of intellectual functioning and adaptive behavior, with onset during the developmental period from infancy through adolescence. Evidence: TAS. Frequency: Frequent (HP:0040282). (ORPHA:96170)
- Seizure (HP:0001250): A seizure is an intermittent abnormality of nervous system physiology characterized by a transient occurrence of signs and/or symptoms due to abnormal excessive or synchronous neuronal activity in the brain. Evidence: TAS. Frequency: Frequent (HP:0040282). (ORPHA:96170)
- Generalized hypotonia (HP:0001290): Generalized muscular hypotonia (abnormally low muscle tone). Evidence: TAS. Frequency: Frequent (HP:0040282). (ORPHA:96170)
- Congenital hip dislocation (HP:0001374). Evidence: TAS. Frequency: Frequent (HP:0040282). (ORPHA:96170)
- Failure to thrive (HP:0001508): Failure to thrive (FTT) refers to a child whose physical growth is substantially below the norm. Evidence: TAS. Frequency: Frequent (HP:0040282). (ORPHA:96170)
- Growth delay (HP:0001510): A deficiency or slowing down of growth pre- and postnatally. Evidence: TAS. Frequency: Frequent (HP:0040282). (ORPHA:96170)
- Pulmonic stenosis (HP:0001642): A narrowing of the right ventricular outflow tract that can occur at the pulmonary valve (valvular stenosis), below the pulmonary valve (infundibular stenosis), or above the pulmonary valve (supravalvar stenosis). Evidence: TAS. Frequency: Frequent (HP:0040282). (ORPHA:96170)
- Aortic valve stenosis (HP:0001650): The presence of a stenosis (narrowing) of the aortic valve. Evidence: TAS. Frequency: Frequent (HP:0040282). (ORPHA:96170)
- Truncus arteriosus (HP:0001660): A single arterial trunk arises from the cardiac mass. The pulmonary arteries, aorta and coronary arteries arise from this single trunk with no evidence of another outflow tract. Evidence: TAS. Frequency: Frequent (HP:0040282). (ORPHA:96170)
- Dysphagia (HP:0002015): Difficulty in swallowing. Evidence: TAS. Frequency: Frequent (HP:0040282). (ORPHA:96170)
- Constipation (HP:0002019): Infrequent or difficult evacuation of feces. Evidence: TAS. Frequency: Frequent (HP:0040282). (ORPHA:96170)
- Gastroesophageal reflux (HP:0002020): A condition in which the stomach contents leak backwards from the stomach into the esophagus through the lower esophageal sphincter. Evidence: TAS. Frequency: Frequent (HP:0040282). (ORPHA:96170)
- Cerebral atrophy (HP:0002059): Atrophy (wasting, decrease in size of cells or tissue) affecting the cerebrum. Evidence: TAS. Frequency: Frequent (HP:0040282). (ORPHA:96170)
- Recurrent respiratory infections (HP:0002205): An increased susceptibility to respiratory infections as manifested by a history of recurrent respiratory infections. Evidence: TAS. Frequency: Frequent (HP:0040282). (ORPHA:96170)
- Low-set nipples (HP:0002562): Placement of the nipples at a lower than normal location. Evidence: TAS. Frequency: Frequent (HP:0040282). (ORPHA:96170)
- Scoliosis (HP:0002650): The presence of an abnormal lateral curvature of the spine. Evidence: TAS. Frequency: Frequent (HP:0040282). (ORPHA:96170)
- Recurrent infections (HP:0002719): Increased susceptibility to infections as manifested by repeated bouts of infection. Evidence: TAS. Frequency: Frequent (HP:0040282). (ORPHA:96170)
- Kyphoscoliosis (HP:0002751): An abnormal curvature of the spine in both a coronal (lateral) and sagittal (back-to-front) plane. Evidence: TAS. Frequency: Frequent (HP:0040282). (ORPHA:96170)
- Ectopic anus (HP:0004397): Abnormal displacement or malposition of the anus. Evidence: TAS. Frequency: Frequent (HP:0040282). (ORPHA:96170)
- Preauricular pit (HP:0004467): Small indentation anterior to the insertion of the ear. Evidence: TAS. Frequency: Frequent (HP:0040282). (ORPHA:96170)
- Supernumerary ribs (HP:0005815): The presence of more than 12 rib pairs. Evidence: TAS. Frequency: Frequent (HP:0040282). (ORPHA:96170)
- Low hanging columella (HP:0009765): Columella extending inferior to the level of the nasal base, when viewed from the side. Evidence: TAS. Frequency: Frequent (HP:0040282). (ORPHA:96170)
- Feeding difficulties (HP:0011968): Impaired ability to eat related to problems gathering food and getting ready to suck, chew, or swallow it. Evidence: TAS. Frequency: Frequent (HP:0040282). (ORPHA:96170)
- Broad jaw (HP:0012802): Bigonial distance (lower facial width) more than 2 SD above the mean (objective); or an apparently increased width of the lower jaw (mandible) when viewed from the front (subjective). Evidence: TAS. Frequency: Frequent (HP:0040282). (ORPHA:96170)
- Hooded eyelid (HP:0030820): Eyelid partly covered by skin when eyes are open. Evidence: TAS. Frequency: Frequent (HP:0040282). (ORPHA:96170)
- Inguinal hernia (HP:0000023): Protrusion of the contents of the abdominal cavity through the inguinal canal. Evidence: TAS. Frequency: Occasional (HP:0040283). (ORPHA:96170)
- Renal hypoplasia (HP:0000089): Hypoplasia of the kidney. Evidence: TAS. Frequency: Occasional (HP:0040283). (ORPHA:96170)
- Unilateral renal agenesis (HP:0000122): A unilateral form of agenesis of the kidney. Evidence: TAS. Frequency: Occasional (HP:0040283). (ORPHA:96170)
- Cleft palate (HP:0000175): Cleft palate is a developmental defect of the palate resulting from a failure of fusion of the palatine processes and manifesting as a separation of the roof of the mouth (soft and hard palate). Evidence: TAS. Frequency: Occasional (HP:0040283). (ORPHA:96170)
- Bifid uvula (HP:0000193): Uvula separated into two parts most easily seen at the tip. Evidence: TAS. Frequency: Occasional (HP:0040283). (ORPHA:96170)
- Hydrocephalus (HP:0000238): Hydrocephalus is an active distension of the ventricular system of the brain resulting from inadequate passage of CSF from its point of production within the cerebral ventricles to its point of absorption into the systemic circulation. Evidence: TAS. Frequency: Occasional (HP:0040283). (ORPHA:96170)
- Microcephaly (HP:0000252): Head circumference below 2 standard deviations below the mean for age and gender. Evidence: TAS. Frequency: Occasional (HP:0040283). (ORPHA:96170)
- Astigmatism (HP:0000483): A type of refraction error associated with abnormal curvatures on the anterior and/or posterior surface of the cornea. Evidence: TAS. Frequency: Occasional (HP:0040283). (ORPHA:96170)
- Ptosis (HP:0000508): The upper eyelid margin is positioned 3 mm or more lower than usual and covers the superior portion of the iris (objective); or, the upper lid margin obscures at least part of the pupil (subjective). Evidence: TAS. Frequency: Occasional (HP:0040283). (ORPHA:96170)
- Hypermetropia (HP:0000540): An abnormality of refraction characterized by the ability to see objects in the distance clearly, while objects nearby appear blurry. Evidence: TAS. Frequency: Occasional (HP:0040283). (ORPHA:96170)
- Congenital diaphragmatic hernia (HP:0000776): The presence of a hernia of the diaphragm present at birth. Evidence: TAS. Frequency: Occasional (HP:0040283). (ORPHA:96170)
- Sacral dimple (HP:0000960): A cutaneous indentation resulting from tethering of the skin to underlying structures (bone) of the intergluteal cleft. Evidence: TAS. Frequency: Occasional (HP:0040283). (ORPHA:96170)
- Agenesis of corpus callosum (HP:0001274): Absence of the corpus callosum as a result of the failure of the corpus callosum to develop, which can be the result of a failure in any one of the multiple steps of callosal development including cellular proliferation and migration, axonal growth or glial patterning at the midline. Evidence: TAS. Frequency: Occasional (HP:0040283). (ORPHA:96170)
- Dandy-Walker malformation (HP:0001305): A congenital brain malformation typically characterized by incomplete formation of the cerebellar vermis, dilation of the fourth ventricle, and enlargement of the posterior fossa. In layman's terms, Dandy Walker malformation is a cyst in the cerebellum (typically symmetrical) that is involved with the fourth ventricle. This may interfere with the ability to drain cerebrospinal fluid from the brain, resulting in hydrocephalus. Dandy Walker cysts are formed during early embryonic development, while the brain forms. The cyst in the cerebellum typically has several blood vessels running through it connecting to the brain, thereby prohibiting surgical removal. Evidence: TAS. Frequency: Occasional (HP:0040283). (ORPHA:96170)
- Intrauterine growth retardation (HP:0001511): An abnormal restriction of fetal growth with fetal weight below the tenth percentile for gestational age. Evidence: TAS. Frequency: Occasional (HP:0040283). (ORPHA:96170)
- Decreased fetal movement (HP:0001558): An abnormal reduction in quantity or strength of fetal movements. Evidence: TAS. Frequency: Occasional (HP:0040283). (ORPHA:96170)
- Oligohydramnios (HP:0001562): Diminished amniotic fluid volume in pregnancy. Evidence: TAS. Frequency: Occasional (HP:0040283). (ORPHA:96170)
- Premature birth (HP:0001622): The birth of a baby of less than 37 weeks of gestational age. Evidence: TAS. Frequency: Occasional (HP:0040283). (ORPHA:96170)
- Breech presentation (HP:0001623): A position of the fetus at delivery in which the fetus enters the birth canal with the buttocks or feet first. Evidence: TAS. Frequency: Occasional (HP:0040283). (ORPHA:96170)
- Ventricular septal defect (HP:0001629): A hole between the two bottom chambers (ventricles) of the heart. The defect is centered around the most superior aspect of the ventricular septum. Evidence: TAS. Frequency: Occasional (HP:0040283). (ORPHA:96170)
- Atrial septal defect (HP:0001631): Atrial septal defect (ASD) is a congenital abnormality of the interatrial septum that enables blood flow between the left and right atria via the interatrial septum. Evidence: TAS. Frequency: Occasional (HP:0040283). (ORPHA:96170)
- Patent ductus arteriosus (HP:0001643): In utero, the ductus arteriosus (DA) serves to divert ventricular output away from the lungs and toward the placenta by connecting the main pulmonary artery to the descending aorta. A patent ductus arteriosus (PDA) in the first 3 days of life is a physiologic shunt in healthy term and preterm newborn infants, and normally is substantially closed within about 24 hours after bith and completely closed after about three weeks. Failure of physiologcal closure is referred to a persistent or patent ductus arteriosus (PDA). Depending on the degree of left-to-right shunting, PDA can have clinical consequences. Evidence: TAS. Frequency: Occasional (HP:0040283). (ORPHA:96170)
- Anal atresia (HP:0002023): Congenital absence of the anus, i.e., the opening at the bottom end of the intestinal tract. Evidence: TAS. Frequency: Occasional (HP:0040283). (ORPHA:96170)
- Ventriculomegaly (HP:0002119): An increase in size of the ventricular system of the brain. Evidence: TAS. Frequency: Occasional (HP:0040283). (ORPHA:96170)
- Chiari malformation (HP:0002308): Chiari malformation consists of a downward displacement of the cerebellar tonsils and the medulla through the foramen magnum, sometimes causing hydrocephalus as a result of obstruction of CSF outflow. Evidence: TAS. Frequency: Occasional (HP:0040283). (ORPHA:96170)
- Abnormal cerebral white matter morphology (HP:0002500): An abnormality of the cerebral white matter. Evidence: TAS. Frequency: Occasional (HP:0040283). (ORPHA:96170)
- Multiple joint contractures (HP:0002828). Evidence: TAS. Frequency: Occasional (HP:0040283). (ORPHA:96170)
- Abnormality of the ankle (HP:0003028): An anomaly of the joint that connects the foot with the leg. Evidence: TAS. Frequency: Occasional (HP:0040283). (ORPHA:96170)
- Recurrent Candida infection (HP:0005401): Increased susceptibility to Candida infections as manifested by recurrent episodes of Candida infection. Evidence: TAS. Frequency: Occasional (HP:0040283). (ORPHA:96170)
- Redundant neck skin (HP:0005989): Excess skin around the neck, often lying in horizontal folds. Evidence: TAS. Frequency: Occasional (HP:0040283). (ORPHA:96170)
- Submucous cleft lip (HP:0009101): A cleft of the lip with overlying mucous membrane. Evidence: TAS. Frequency: Occasional (HP:0040283). (ORPHA:96170)
- Severe hearing impairment (HP:0012714): A severe form of hearing impairment. Evidence: TAS. Frequency: Occasional (HP:0040283). (ORPHA:96170)
- Cough (HP:0012735): A sudden, audible expulsion of air from the lungs through a partially closed glottis, preceded by inhalation. Evidence: TAS. Frequency: Occasional (HP:0040283). (ORPHA:96170)